Phenotypes associated with the disease Parkinson disease 17 (OMIM:614203):
- Resting tremor (HP:0002322): A resting tremor occurs when muscles are at rest and becomes less noticeable or disappears when the affected muscles are moved. Resting tremors are often slow and coarse. Evidence: TAS. (OMIM:614203)
- Bradykinesia (HP:0002067): Bradykinesia literally means slow movement, and is used clinically to denote a slowness in the execution of movement (in contrast to hypokinesia, which is used to refer to slowness in the initiation of movement). Evidence: TAS. (OMIM:614203)
- Parkinsonism (HP:0001300): Characteristic neurologic anomaly resulting from degeneration of dopamine-generating cells in the substantia nigra, a region of the midbrain, characterized clinically by shaking, rigidity, slowness of movement and difficulty with walking and gait. Evidence: TAS. (OMIM:614203)
- Rigidity (HP:0002063): Continuous involuntary sustained muscle contraction. When an affected muscle is passively stretched, the degree of resistance remains constant regardless of the rate at which the muscle is stretched. This feature helps to distinguish rigidity from muscle spasticity. Evidence: TAS. (OMIM:614203)
- Adult onset (HP:0003581): Onset of disease manifestations in adulthood, defined here as at the age of 16 years or later. Evidence: PCS. (PMID:21763482)
- Postural instability (HP:0002172): A tendency to fall or the inability to keep oneself from falling; imbalance. The retropulsion test is widely regarded as the gold standard to evaluate postural instability, Use of the retropulsion test includes a rapid balance perturbation in the backward direction, and the number of balance correcting steps (or total absence thereof) is used to rate the degree of postural instability. Healthy subjects correct such perturbations with either one or two large steps, or without taking any steps, hinging rapidly at the hips while swinging the arms forward as a counterweight. In patients with balance impairment, balance correcting steps are often too small, forcing patients to take more than two steps. Taking three or more steps is generally considered to be abnormal, and taking more than five steps is regarded as being clearly abnormal. Markedly affected patients continue to step backward without ever regaining their balance and must be caught by the examiner (this would be called true retropulsion). Even more severely affected patients fail to correct entirely, and fall backward like a pushed toy soldier, without taking any corrective steps. Evidence: TAS. (OMIM:614203)
- Akinesia (HP:0002304): Inability to initiate changes in activity or movement and to perform ordinary volitional movements rapidly and easily. Evidence: TAS. (OMIM:614203)
- Autosomal dominant inheritance (HP:0000006): A mode of inheritance that is observed for traits related to a gene encoded on one of the autosomes (i.e., the human chromosomes 1-22) in which a trait manifests in heterozygotes. In the context of medical genetics, an autosomal dominant disorder is caused when a single copy of the mutant allele is present. Males and females are affected equally, and can both transmit the disorder with a risk of 50% for each child of inheriting the mutant allele. Evidence: PCS. (PMID:21763482)
- Tremor (HP:0001337): An unintentional, oscillating to-and-fro muscle movement about a joint axis. Evidence: TAS. (OMIM:614203)
- Dyskinesia (HP:0100660): A movement disorder which consists of effects including diminished voluntary movements and the presence of involuntary movements. Evidence: TAS. (OMIM:614203)